Phenotypes associated with the disease Familial scaphocephaly syndrome, McGillivray type (ORPHA:168624):
- High palate (HP:0000218): Height of the palate more than 2 SD above the mean (objective) or palatal height at the level of the first permanent molar more than twice the height of the teeth (subjective). Evidence: TAS. Frequency: Frequent (HP:0040282). (ORPHA:168624)
- Trigonocephaly (HP:0000243): Wedge-shaped, or triangular head, with the apex of the triangle at the midline of the forehead and the base of the triangle at the occiput. Evidence: TAS. Frequency: Occasional (HP:0040283). (ORPHA:168624)
- Macrocephaly (HP:0000256): Occipitofrontal (head) circumference greater than 97th centile compared to appropriate, age matched, sex-matched normal standards. Alternatively, a apparently increased size of the cranium. Evidence: TAS. Frequency: Very frequent (HP:0040281). (ORPHA:168624)
- Dolichocephaly (HP:0000268): An abnormality of skull shape characterized by a increased anterior-posterior diameter, i.e., an increased antero-posterior dimension of the skull. Cephalic index less than 76%. Alternatively, an apparently increased antero-posterior length of the head compared to width. Often due to premature closure of the sagittal suture. Evidence: TAS. Frequency: Frequent (HP:0040282). (ORPHA:168624)
- Mandibular prognathia (HP:0000303): Abnormal prominence of the chin related to increased length of the mandible. Evidence: TAS. Frequency: Occasional (HP:0040283). (ORPHA:168624)
- Hypertelorism (HP:0000316): Interpupillary distance more than 2 SD above the mean (alternatively, the appearance of an increased interpupillary distance or widely spaced eyes). Evidence: TAS. Frequency: Very frequent (HP:0040281). (ORPHA:168624)
- High forehead (HP:0000348): An abnormally increased height of the forehead. Evidence: TAS. Frequency: Very frequent (HP:0040281). (ORPHA:168624)
- Upslanted palpebral fissure (HP:0000582): The palpebral fissure inclination is more than two standard deviations above the mean for age (objective); or, the inclination of the palpebral fissure is greater than typical for age. Evidence: TAS. Frequency: Occasional (HP:0040283). (ORPHA:168624)
- Mild intellectual disability (HP:0001256): Mild intellectual disability (ID) is defined as a type of ID characterized by mildly sub-average adaptive functioning and intellectual functioning, with an intelligence quotient (IQ) the range of 50-69. Evidence: TAS. Frequency: Frequent (HP:0040282). (ORPHA:168624)
- Toe syndactyly (HP:0001770): Webbing or fusion of the toes, involving soft parts only or including bone structure. Bony fusions are referred to as "bony" Syndactyly if the fusion occurs in a radio-ulnar axis. Fusions of bones of the toes in a proximo-distal axis are referred to as "Symphalangism". Evidence: TAS. Frequency: Occasional (HP:0040283). (ORPHA:168624)
- Ventriculomegaly (HP:0002119): An increase in size of the ventricular system of the brain. Evidence: TAS. Frequency: Occasional (HP:0040283). (ORPHA:168624)
- Broad hallux phalanx (HP:0010059): An increase in width in one or more phalanges of the big toe. Evidence: TAS. Frequency: Occasional (HP:0040283). (ORPHA:168624)
- Open bite (HP:0010807): Visible space between the dental arches in occlusion. Evidence: TAS. Frequency: Frequent (HP:0040282). (ORPHA:168624)
- Midface retrusion (HP:0011800): Posterior positions and/or vertical shortening of the infraorbital and perialar regions, or increased concavity of the face and/or reduced nasolabial angle. Evidence: TAS. Frequency: Frequent (HP:0040282). (ORPHA:168624)